- Horseshoe kidney (HP:0000085): A connection of the right and left kidney by an isthmus of functioning renal parenchyma or fibrous tissue that crosses the midline. Evidence: TAS. Frequency: Occasional (HP:0040283). (ORPHA:94063)
- Ectopic kidney (HP:0000086): A developmental defect in which a kidney is located in an abnormal anatomic position. Evidence: TAS. Frequency: Occasional (HP:0040283). (ORPHA:94063)
- Renal hypoplasia (HP:0000089): Hypoplasia of the kidney. Evidence: TAS. Frequency: Occasional (HP:0040283). (ORPHA:94063)
- Thin vermilion border (HP:0000233): Height of the vermilion of the medial part of the lip more than 2 SD below the mean, or apparently reduced height of the vermilion of the lip in the frontal view. The vermilion is the red part of the lips (and confusingly, the vermilion itself is also often referred to as being equivalent the lips). Evidence: TAS. Frequency: Occasional (HP:0040283). (ORPHA:94063)
- Microcephaly (HP:0000252): Head circumference below 2 standard deviations below the mean for age and gender. Evidence: TAS. Frequency: Occasional (HP:0040283). (ORPHA:94063)
- Hypertelorism (HP:0000316): Interpupillary distance more than 2 SD above the mean (alternatively, the appearance of an increased interpupillary distance or widely spaced eyes). Evidence: TAS. Frequency: Very frequent (HP:0040281). (ORPHA:94063)
- Triangular face (HP:0000325): Facial contour, as viewed from the front, triangular in shape, with breadth at the temples and tapering to a narrow chin. Evidence: TAS. Frequency: Occasional (HP:0040283). (ORPHA:94063)
- Micrognathia (HP:0000347): Developmental hypoplasia of the mandible. Evidence: TAS. Frequency: Occasional (HP:0040283). (ORPHA:94063)
- Prominent nasal bridge (HP:0000426): Anterior positioning of the nasal root in comparison to the usual positioning for age. Evidence: TAS. Frequency: Occasional (HP:0040283). (ORPHA:94063)
- Wide nose (HP:0000445): Interalar distance more than two standard deviations above the mean for age, i.e., an apparently increased width of the nasal base and alae. Evidence: TAS. Frequency: Occasional (HP:0040283). (ORPHA:94063)
- Deeply set eye (HP:0000490): An eye that is more deeply recessed into the plane of the face than is typical. Evidence: TAS. Frequency: Occasional (HP:0040283). (ORPHA:94063)
- Thick eyebrow (HP:0000574): Increased density/number and/or increased diameter of eyebrow hairs. Evidence: TAS. Frequency: Occasional (HP:0040283). (ORPHA:94063)
- Synophrys (HP:0000664): Meeting of the medial eyebrows in the midline. Evidence: TAS. Frequency: Occasional (HP:0040283). (ORPHA:94063)
- Hypodontia (HP:0000668): The absence of five or less teeth from the normal series by a failure to develop. Evidence: TAS. Frequency: Occasional (HP:0040283). (ORPHA:94063)
- Delayed speech and language development (HP:0000750): A degree of language development that is significantly below the norm for a child of a specified age. Evidence: TAS. Frequency: Very frequent (HP:0040281). (ORPHA:94063)
- Diabetes mellitus (HP:0000819): A group of abnormalities characterized by hyperglycemia and glucose intolerance. Evidence: TAS. Frequency: Occasional (HP:0040283). (ORPHA:94063)
- Hyperpigmentation of the skin (HP:0000953): A darkening of the skin related to an increase in melanin production and deposition. Evidence: TAS. Frequency: Frequent (HP:0040282). (ORPHA:94063)
- Hypotonia (HP:0001252): Hypotonia is an abnormally low muscle tone (the amount of tension or resistance to movement in a muscle). Even when relaxed, muscles have a continuous and passive partial contraction which provides some resistance to passive stretching. Hypotonia thus manifests as diminished resistance to passive stretching. Hypotonia is not the same as muscle weakness, although the two conditions can co-exist. Evidence: TAS. Frequency: Occasional (HP:0040283). (ORPHA:94063)
- Mild intellectual disability (HP:0001256): Mild intellectual disability (ID) is defined as a type of ID characterized by mildly sub-average adaptive functioning and intellectual functioning, with an intelligence quotient (IQ) the range of 50-69. Evidence: TAS. Frequency: Very frequent (HP:0040281). (ORPHA:94063)
- Global developmental delay (HP:0001263): A delay in the achievement of motor or mental milestones in the domains of development of a child, including motor skills, speech and language, cognitive skills, and social and emotional skills. This term should only be used to describe children younger than five years of age. Evidence: TAS. Frequency: Very frequent (HP:0040281). (ORPHA:94063)
- Specific learning disability (HP:0001328): Impairment of certain skills such as reading or writing, coordination, self-control, or attention that interfere with the ability to learn. The impairment is not related to a global deficiency of intelligence. Evidence: TAS. Frequency: Very frequent (HP:0040281). (ORPHA:94063)
- Tremor (HP:0001337): An unintentional, oscillating to-and-fro muscle movement about a joint axis. Evidence: TAS. Frequency: Frequent (HP:0040282). (ORPHA:94063)
- Subcutaneous nodule (HP:0001482): Slightly elevated lesions on or in the skin with a diameter of over 5 mm. Evidence: TAS. Frequency: Occasional (HP:0040283). (ORPHA:94063)
- Failure to thrive (HP:0001508): Failure to thrive (FTT) refers to a child whose physical growth is substantially below the norm. Evidence: TAS. Frequency: Very frequent (HP:0040281). (ORPHA:94063)
- Intrauterine growth retardation (HP:0001511): An abnormal restriction of fetal growth with fetal weight below the tenth percentile for gestational age. Evidence: TAS. Frequency: Very frequent (HP:0040281). (ORPHA:94063)
- Abnormality of the spleen (HP:0001743): An abnormality of the spleen. Evidence: TAS. Frequency: Occasional (HP:0040283). (ORPHA:94063)
- Frontal bossing (HP:0002007): Bilateral bulging of the lateral frontal bone prominences with relative sparing of the midline. Evidence: TAS. Frequency: Occasional (HP:0040283). (ORPHA:94063)
- Chiari malformation (HP:0002308): Chiari malformation consists of a downward displacement of the cerebellar tonsils and the medulla through the foramen magnum, sometimes causing hydrocephalus as a result of obstruction of CSF outflow. Evidence: TAS. Frequency: Occasional (HP:0040283). (ORPHA:94063)
- Intestinal malrotation (HP:0002566): An abnormality of the intestinal rotation and fixation that normally occurs during the development of the gut. This can lead to volvulus, or twisting of the intestine that causes obstruction and necrosis. Evidence: TAS. Frequency: Occasional (HP:0040283). (ORPHA:94063)
- Scoliosis (HP:0002650): The presence of an abnormal lateral curvature of the spine. Evidence: TAS. Frequency: Occasional (HP:0040283). (ORPHA:94063)
- Downturned corners of mouth (HP:0002714): A morphological abnormality of the mouth in which the angle of the mouth is downturned. The oral commissures are positioned inferior to the midline labial fissure. Evidence: TAS. Frequency: Occasional (HP:0040283). (ORPHA:94063)
- Skeletal muscle atrophy (HP:0003202): The presence of skeletal muscular atrophy (which is also known as amyotrophy). Evidence: TAS. Frequency: Occasional (HP:0040283). (ORPHA:94063)
- Syringomyelia (HP:0003396): Dilated, glial-lined cavity in spinal cord. This cavity does not communicate with the central canal, and usually is between the dorsal columns unilaterally or bilaterally along the side of the cord. Evidence: TAS. Frequency: Occasional (HP:0040283). (ORPHA:94063)
- Clinodactyly of the 5th finger (HP:0004209): Clinodactyly refers to a bending or curvature of the fifth finger in the radial direction (i.e., towards the 4th finger). Evidence: TAS. Frequency: Occasional (HP:0040283). (ORPHA:94063)
- Short stature (HP:0004322): A height below that which is expected according to age and gender norms. Although there is no universally accepted definition of short stature, many refer to "short stature" as height more than 2 standard deviations below the mean for age and gender (or below the 3rd percentile for age and gender dependent norms). Evidence: TAS. Frequency: Very frequent (HP:0040281). (ORPHA:94063)
- Abnormal nostril morphology (HP:0005288): Abnormality of the nostril. Evidence: TAS. Frequency: Occasional (HP:0040283). (ORPHA:94063)
- Osteopoikilosis (HP:0010739): Osteopoikilosis is a benign, asymptomatic sclerotic dysplasia of the bones. It affects both male and female and may be seen at any age. Radiographically sclerotic circular or ovoid lesions are usually symmetrically distributed in a periarticular location. Lesions can increase or decrease in size and number in serial radiographs or even disappear and do not have increased bone radiotracer uptake. Evidence: TAS. Frequency: Frequent (HP:0040282). (ORPHA:94063)
These phenotypes are associated with the disease 12q14 microdeletion syndrome (ORPHA:94063).